- Prosopagnosia (HP:0010528): Inability to recognize faces of familiar persons. Evidence: IEA. (OMIM:610382)
- Autosomal dominant inheritance (HP:0000006): A mode of inheritance that is observed for traits related to a gene encoded on one of the autosomes (i.e., the human chromosomes 1-22) in which a trait manifests in heterozygotes. In the context of medical genetics, an autosomal dominant disorder is caused when a single copy of the mutant allele is present. Males and females are affected equally, and can both transmit the disorder with a risk of 50% for each child of inheriting the mutant allele. Evidence: TAS. (OMIM:610382)
These phenotypes are associated with the disease prosopagnosia, hereditary (OMIM:610382).